Phenotypes associated with the disease Homocystinuria due to cystathionine beta-synthase deficiency (ORPHA:394):
- Dental crowding (HP:0000678): Changes in alignment of teeth in the dental arch. Evidence: TAS. Frequency: Very frequent (HP:0040281). (ORPHA:394)
- Osteoporosis (HP:0000939): Osteoporosis is a systemic skeletal disease characterized by low bone density and microarchitectural deterioration of bone tissue with a consequent increase in bone fragility. According to the WHO criteria, osteoporosis is defined as a BMD that lies 2.5 standard deviations or more below the average value for young healthy adults (a T-score below -2.5 SD). Evidence: TAS. Frequency: Very frequent (HP:0040281). (ORPHA:394)
- Ectopia lentis (HP:0001083): Dislocation or malposition of the crystalline lens of the eye. A partial displacement (or dislocation) of the lens is described as a subluxation of the lens, while a complete displacement is termed luxation of the lens. A complete displacement occurs if the lens is completely outside the patellar fossa of the lens, either in the anterior chamber, in the vitreous, or directly on the retina. If the lens is partially displaced but still contained within the lens space, then it is termed subluxation. Evidence: TAS. Frequency: Very frequent (HP:0040281). (ORPHA:394)
- Arachnodactyly (HP:0001166): Abnormally long and slender fingers (spider fingers). Evidence: TAS. Frequency: Very frequent (HP:0040281). (ORPHA:394)
- Intellectual disability (HP:0001249): The term intellectual disability or intellectual developmental disorder is used to describe significantly sub-average intellectual and adaptive functioning based on clinical assessment and as measured by individually administered, appropriately normed, standardized and validated tests of intellectual functioning and adaptive behavior, with onset during the developmental period from infancy through adolescence. Evidence: TAS. Frequency: Very frequent (HP:0040281). (ORPHA:394)
- Disproportionate tall stature (HP:0001519): A tall and slim body build with increased arm span to height ratio (>1.05) and a reduced upper-to-lower segment ratio (<0.85), i.e., unusually long arms and legs. The extremities as well as the hands and feet are unusually slim. Evidence: TAS. Frequency: Very frequent (HP:0040281). (ORPHA:394)
- Hyperhomocystinemia (HP:0002160): An increased concentration of homocystine in the blood. Evidence: TAS. Frequency: Very frequent (HP:0040281). (ORPHA:394)
- Recurrent fractures (HP:0002757): The repeated occurrence of bone fractures (implying an abnormally increased tendency for fracture). Evidence: TAS. Frequency: Very frequent (HP:0040281). (ORPHA:394)
- Abnormality of amino acid metabolism (HP:0004337): Abnormality of an amino acid metabolic process. Evidence: TAS. Frequency: Very frequent (HP:0040281). (ORPHA:394)
- Myopia (HP:0000545): An abnormality of refraction characterized by the ability to see objects nearby clearly, while objects in the distance appear blurry. Evidence: TAS. Frequency: Frequent (HP:0040282). (ORPHA:394)
- Amblyopia (HP:0000646): Reduced visual acuity that is uncorrectable by lenses in the absence of detectable anatomic defects in the eye or visual pathways. Evidence: TAS. Frequency: Frequent (HP:0040282). (ORPHA:394)
- Pectus excavatum (HP:0000767): A defect of the chest wall characterized by a depression of the sternum, giving the chest ("pectus") a caved-in ("excavatum") appearance. Evidence: TAS. Frequency: Frequent (HP:0040282). (ORPHA:394)
- Pectus carinatum (HP:0000768): A deformity of the chest caused by overgrowth of the ribs and characterized by protrusion of the sternum. Evidence: TAS. Frequency: Frequent (HP:0040282). (ORPHA:394)
- Hypertension (HP:0000822): The presence of chronic increased pressure in the systemic arterial system. Evidence: TAS. Frequency: Frequent (HP:0040282). (ORPHA:394)
- Joint stiffness (HP:0001387): Joint stiffness is a perceived sensation of tightness in a joint or joints when attempting to move them after a period of inactivity. Joint stiffness typically subsides over time. Evidence: TAS. Frequency: Frequent (HP:0040282). (ORPHA:394)
- Pes cavus (HP:0001761): An increase in height of the medial longitudinal arch of the foot that does not flatten on weight bearing (i.e., a distinctly hollow form of the sole of the foot when it is bearing weight). Evidence: TAS. Frequency: Frequent (HP:0040282). (ORPHA:394)
- Pulmonary embolism (HP:0002204): An embolus (that is, an abnormal particle circulating in the blood) located in the pulmonary artery and thereby blocking blood circulation to the lung. Usually the embolus is a blood clot that has developed in an extremity (for instance, a deep venous thrombosis), detached, and traveled through the circulation before becoming trapped in the pulmonary artery. Evidence: TAS. Frequency: Frequent (HP:0040282). (ORPHA:394)
- Sparse scalp hair (HP:0002209): Decreased number of hairs per unit area of skin of the scalp. Evidence: TAS. Frequency: Frequent (HP:0040282). (ORPHA:394)
- Cerebral ischemia (HP:0002637): Restriction of arterial blood supply to the brain associated with insufficient oxygenation to support the metabolic requirements of the tissue. Evidence: TAS. Frequency: Frequent (HP:0040282). (ORPHA:394)
- Scoliosis (HP:0002650): The presence of an abnormal lateral curvature of the spine. Evidence: TAS. Frequency: Frequent (HP:0040282). (ORPHA:394)
- Kyphosis (HP:0002808): Exaggerated anterior convexity of the thoracic vertebral column. Evidence: TAS. Frequency: Frequent (HP:0040282). (ORPHA:394)
- Genu valgum (HP:0002857): The legs angle inward, such that the knees are close together and the ankles far apart. Evidence: TAS. Frequency: Frequent (HP:0040282). (ORPHA:394)
- Arterial thrombosis (HP:0004420): The formation of a blood clot inside an artery. Evidence: TAS. Frequency: Frequent (HP:0040282). (ORPHA:394)
- Venous thrombosis (HP:0004936): Formation of a blood clot (thrombus) inside a vein, causing the obstruction of blood flow. Evidence: TAS. Frequency: Frequent (HP:0040282). (ORPHA:394)
- Arteriovenous malformation (HP:0100026): An anomalous configuration of blood vessels that shunts arterial blood directly into veins without passing through the capillaries. Evidence: TAS. Frequency: Frequent (HP:0040282). (ORPHA:394)
- High palate (HP:0000218): Height of the palate more than 2 SD above the mean (objective) or palatal height at the level of the first permanent molar more than twice the height of the teeth (subjective). Evidence: TAS. Frequency: Occasional (HP:0040283). (ORPHA:394)
- Strabismus (HP:0000486): A misalignment of the eyes so that the visual axes deviate from bifoveal fixation. The classification of strabismus may be based on a number of features including the relative position of the eyes, whether the deviation is latent or manifest, intermittent or constant, concomitant or otherwise and according to the age of onset and the relevance of any associated refractive error. Evidence: TAS. Frequency: Occasional (HP:0040283). (ORPHA:394)
- Glaucoma (HP:0000501): Glaucoma refers loss of retinal ganglion cells in a characteristic pattern of optic neuropathy usually associated with increased intraocular pressure. Evidence: TAS. Frequency: Occasional (HP:0040283). (ORPHA:394)
- Cataract (HP:0000518): A cataract is an opacity or clouding that develops in the crystalline lens of the eye or in its capsule. Evidence: TAS. Frequency: Occasional (HP:0040283). (ORPHA:394)
- Retinal detachment (HP:0000541): Separation of the inner layers of the retina (neural retina) from the pigment epithelium. Evidence: TAS. Frequency: Occasional (HP:0040283). (ORPHA:394)
- Optic atrophy (HP:0000648): Atrophy of the optic nerve. Optic atrophy results from the death of the retinal ganglion cell axons that comprise the optic nerve and manifesting as a pale optic nerve on fundoscopy. Evidence: TAS. Frequency: Occasional (HP:0040283). (ORPHA:394)
- Atypical behavior (HP:0000708): Atypical behavior is an abnormality in a person's actions that can be controlled or modulated by the will of the individual. While abnormal behaviors can be difficult to control, they are distinct from other abnormal actions that cannot be affected by the individual's will. Evidence: TAS. Frequency: Occasional (HP:0040283). (ORPHA:394)
- Psychosis (HP:0000709): A condition characterized by changes in personality and thought patterns, often accompanied by hallucinations and delusional beliefs, is known as psychosis. Evidence: TAS. Frequency: Occasional (HP:0040283). (ORPHA:394)
- Depression (HP:0000716): Frequently experiencing feelings of being down, miserable, and/or hopeless; struggling to recover from these moods; having a pessimistic outlook on the future; feeling a pervasive sense of shame; having a low self-worth; experiencing thoughts of suicide and engaging in suicidal behavior. Evidence: TAS. Frequency: Occasional (HP:0040283). (ORPHA:394)
- Autistic behavior (HP:0000729): Persistent deficits in social interaction and communication and interaction as well as a markedly restricted repertoire of activity and interest as well as repetitive patterns of behavior. Evidence: TAS. Frequency: Occasional (HP:0040283). (ORPHA:394)
- Anxiety (HP:0000739): Intense feelings of nervousness, tension, or panic often arise in response to interpersonal stresses. There is worry about the negative effects of past unpleasant experiences and future negative possibilities. Individuals may feel fearful, apprehensive, or threatened by uncertainty, and they may also have fears of falling apart or losing control. Evidence: TAS. Frequency: Occasional (HP:0040283). (ORPHA:394)
- Hypopigmentation of the skin (HP:0001010): A reduction of skin color related to a decrease in melanin production and deposition. Evidence: TAS. Frequency: Occasional (HP:0040283). (ORPHA:394)
- Urticaria (HP:0001025): Raised, well-circumscribed areas of erythema and edema involving the dermis and epidermis. Urticaria is intensely pruritic, and blanches completely with pressure. Evidence: TAS. Frequency: Occasional (HP:0040283). (ORPHA:394)
- Lens subluxation (HP:0001132): Partial dislocation of the lens of the eye. Evidence: TAS. Frequency: Occasional (HP:0040283). (ORPHA:394)
- Seizure (HP:0001250): A seizure is an intermittent abnormality of nervous system physiology characterized by a transient occurrence of signs and/or symptoms due to abnormal excessive or synchronous neuronal activity in the brain. Evidence: TAS. Frequency: Occasional (HP:0040283). (ORPHA:394)
- Parkinsonism (HP:0001300): Characteristic neurologic anomaly resulting from degeneration of dopamine-generating cells in the substantia nigra, a region of the midbrain, characterized clinically by shaking, rigidity, slowness of movement and difficulty with walking and gait. Evidence: TAS. Frequency: Occasional (HP:0040283). (ORPHA:394)
- Specific learning disability (HP:0001328): Impairment of certain skills such as reading or writing, coordination, self-control, or attention that interfere with the ability to learn. The impairment is not related to a global deficiency of intelligence. Evidence: TAS. Frequency: Occasional (HP:0040283). (ORPHA:394)
- Dystonia (HP:0001332): An abnormally increased muscular tone that causes fixed abnormal postures. There is a slow, intermittent twisting motion that leads to exaggerated turning and posture of the extremities and trunk. Evidence: TAS. Frequency: Occasional (HP:0040283). (ORPHA:394)
- Pancreatitis (HP:0001733): The presence of inflammation in the pancreas. Evidence: TAS. Frequency: Occasional (HP:0040283). (ORPHA:394)
- Subcutaneous hemorrhage (HP:0001933): This term refers to an abnormally increased susceptibility to bruising (purpura, petechiae, or ecchymoses). Evidence: TAS. Frequency: Occasional (HP:0040283). (ORPHA:394)
- Anorexia (HP:0002039): Lack of desire to eat (loss of appetite). Evidence: TAS. Frequency: Occasional (HP:0040283). (ORPHA:394)
- Esophageal varix (HP:0002040): Extreme dilation of the submucusoal veins in the lower portion of the esophagus. Evidence: TAS. Frequency: Occasional (HP:0040283). (ORPHA:394)
- Abnormality of extrapyramidal motor function (HP:0002071): A neurological condition related to lesions of the basal ganglia leading to typical abnormalities including akinesia (inability to initiate changes in activity and perform volitional movements rapidly and easily), muscular rigidity (continuous contraction of muscles with constant resistance to passive movement), chorea (widespread arrhythmic movements of a forcible, rapid, jerky, and restless nature), athetosis (inability to sustain the muscles of the fingers, toes, or other group of muscles in a fixed position), and akathisia (inability to remain motionless). Evidence: TAS. Frequency: Occasional (HP:0040283). (ORPHA:394)
- Intracranial hemorrhage (HP:0002170): Hemorrhage occurring within the skull. Evidence: TAS. Frequency: Occasional (HP:0040283). (ORPHA:394)
- Gastrointestinal hemorrhage (HP:0002239): Hemorrhage affecting the gastrointestinal tract. Evidence: TAS. Frequency: Occasional (HP:0040283). (ORPHA:394)
- Hepatomegaly (HP:0002240): Abnormally increased size of the liver. Evidence: TAS. Frequency: Occasional (HP:0040283). (ORPHA:394)
- EEG abnormality (HP:0002353): Abnormality observed by electroencephalogram (EEG), which is used to record of the brain's spontaneous electrical activity from multiple electrodes placed on the scalp. Evidence: TAS. Frequency: Occasional (HP:0040283). (ORPHA:394)
- Abnormal cerebral white matter morphology (HP:0002500): An abnormality of the cerebral white matter. Evidence: TAS. Frequency: Occasional (HP:0040283). (ORPHA:394)
- Elevated circulating hepatic transaminase concentration (HP:0002910): Elevations of the levels of SGOT and SGPT in the serum. SGOT (serum glutamic oxaloacetic transaminase) and SGPT (serum glutamic pyruvic transaminase) are transaminases primarily found in the liver and heart and are released into the bloodstream as the result of liver or heart damage. SGOT and SGPT are used clinically mainly as markers of liver damage. Evidence: TAS. Frequency: Occasional (HP:0040283). (ORPHA:394)
- Hemiplegia/hemiparesis (HP:0004374): Loss of strength in the arm, leg, and sometimes face on one side of the body. Hemiplegia refers to a severe or complete loss of strength, whereas hemiparesis refers to a relatively mild loss of strength. Evidence: TAS. Frequency: Occasional (HP:0040283). (ORPHA:394)
- Abnormal retinal pigmentation (HP:0007703): Any deviation from the normal pigmentation of the retina. Evidence: TAS. Frequency: Occasional (HP:0040283). (ORPHA:394)
- Obsessive-compulsive trait (HP:0008770): The presence of one or more obsessive-compulsive personality traits. Obsessions refer to persistent intrusive thoughts, and compulsions to intrusive behaviors, which the affected person experiences as involuntary, senseless, or repugnant. Evidence: TAS. Frequency: Occasional (HP:0040283). (ORPHA:394)
- Neurodevelopmental delay (HP:0012758): Neurodevelopmental delay (NDD) refers to delays in the maturation of the brain and central nervous system; infants and young children with NDD may experience delays in the development of one or more skills including gross motor abilities, fine-motor coordination, language abilities and ability to solve increasingly complex problems. Evidence: TAS. Frequency: Occasional (HP:0040283). (ORPHA:394)
- Malar rash (HP:0025300): An erythematous (red), flat facial rash that affects the skin in the malar area (over the cheekbones) and extends over the bridge of the nose. Evidence: TAS. Frequency: Occasional (HP:0040283). (ORPHA:394)
- Livedo reticularis (HP:0033505): Livedo reticularis is characterized by the presence of a bluish purple, mottled or netlike pattern in unbroken circles on the skin. Exposure to cold environments usually intensifies the vascular pattern. Presumably, the condition results from slow or stagnant blood flow, vessel-wall pathology, and decreased oxygen tension. Evidence: TAS. Frequency: Occasional (HP:0040283). (ORPHA:394)
- Cerebral venous sinus thrombosis (HP:0033724): An intracranial thrombosis of the venous sinuses. These typically present with headache, seizures or venous stroke secondary to raised cerebral venous pressure. Cerebral venous sinus thromboses usually affect larger areas of brain parenchyma than those affected by cerebral vein thromboses. Evidence: TAS. Frequency: Occasional (HP:0040283). (ORPHA:394)
- Hernia (HP:0100790). Evidence: TAS. Frequency: Occasional (HP:0040283). (ORPHA:394)